- Jejunal atresia (HP:0005235): A developmental defect resulting in abnormal closure, or atresia of the tubular structure of the jejunum. Evidence: TAS. (OMIM:243600)
- Abnormal abdomen morphology (HP:0001438): A structural abnormality of the abdomen ('belly'), that is, the part of the body between the pelvis and the thorax. Evidence: IEA. (OMIM:243600)
- Autosomal recessive inheritance (HP:0000007): A mode of inheritance that is observed for traits related to a gene encoded on one of the autosomes (i.e., the human chromosomes 1-22) in which a trait manifests in individuals with two pathogenic alleles, either homozygotes (two copies of the same mutant allele) or compound heterozygotes (whereby each copy of a gene has a distinct mutant allele). Evidence: IEA. (OMIM:243600)
These phenotypes are associated with the disease atresia of small intestine (OMIM:243600).